Phenotypes associated with the disease Lynch syndrome 4 (OMIM:614337):
- Hereditary nonpolyposis colorectal carcinoma (HP:0006716). Evidence: TAS. (OMIM:614337)
- Ovarian neoplasm (HP:0100615): A tumor (abnormal growth of tissue) of the ovary. Evidence: TAS. (OMIM:614337)
- Endometrial carcinoma (HP:0012114): A carcinoma of the endometrium, the mucous lining of the uterus. Evidence: TAS. (OMIM:614337)
- Autosomal dominant inheritance (HP:0000006): A mode of inheritance that is observed for traits related to a gene encoded on one of the autosomes (i.e., the human chromosomes 1-22) in which a trait manifests in heterozygotes. In the context of medical genetics, an autosomal dominant disorder is caused when a single copy of the mutant allele is present. Males and females are affected equally, and can both transmit the disorder with a risk of 50% for each child of inheriting the mutant allele. Evidence: TAS. (OMIM:614337)